- Glaucoma (HP:0000501): Glaucoma refers loss of retinal ganglion cells in a characteristic pattern of optic neuropathy usually associated with increased intraocular pressure. Evidence: TAS. Frequency: Very frequent (HP:0040281). (ORPHA:3449)
- Brachydactyly (HP:0001156): Digits that appear disproportionately short compared to the hand/foot. The word brachydactyly is used here to describe a series distinct patterns of shortened digits (brachydactyly types A-E). This is the sense used here. Evidence: TAS. Frequency: Very frequent (HP:0040281). (ORPHA:3449)
- Short stature (HP:0004322): A height below that which is expected according to age and gender norms. Although there is no universally accepted definition of short stature, many refer to "short stature" as height more than 2 standard deviations below the mean for age and gender (or below the 3rd percentile for age and gender dependent norms). Evidence: TAS. Frequency: Very frequent (HP:0040281). (ORPHA:3449)
- Short thumb (HP:0009778): Hypoplasia (congenital reduction in size) of the thumb. Evidence: TAS. Frequency: Very frequent (HP:0040281). (ORPHA:3449)
- High myopia (HP:0011003): A severe form of myopia with greater than -6.00 diopters. Evidence: TAS. Frequency: Very frequent (HP:0040281). (ORPHA:3449)
- Microspherophakia (HP:0030961): Microspherophakia is a rare congenital anomaly characterized by the abnormal spherical shape of the crystalline lens. It is characterized by an increased anteroposterior thickness of the lens associated with reduced equatorial diameter. The primary pathology lies in the development of zonules. The condition is often bilateral and is characterized by small, thick, and spherical lenses. Evidence: TAS. Frequency: Very frequent (HP:0040281). (ORPHA:3449)
- Thickened skin (HP:0001072): Laminar thickening of skin. Evidence: TAS. Frequency: Frequent (HP:0040282). (ORPHA:3449)
- Ectopia lentis (HP:0001083): Dislocation or malposition of the crystalline lens of the eye. A partial displacement (or dislocation) of the lens is described as a subluxation of the lens, while a complete displacement is termed luxation of the lens. A complete displacement occurs if the lens is completely outside the patellar fossa of the lens, either in the anterior chamber, in the vitreous, or directly on the retina. If the lens is partially displaced but still contained within the lens space, then it is termed subluxation. Evidence: TAS. Frequency: Frequent (HP:0040282). (ORPHA:3449)
- Limitation of joint mobility (HP:0001376): A reduction in the freedom of movement of one or more joints. Evidence: TAS. Frequency: Frequent (HP:0040282). (ORPHA:3449)
- Abnormal cardiovascular system morphology (HP:0030680): Any structural anomaly of the heart and blood vessels. Evidence: TAS. Frequency: Frequent (HP:0040282). (ORPHA:3449)
- Cataract (HP:0000518): A cataract is an opacity or clouding that develops in the crystalline lens of the eye or in its capsule. Evidence: TAS. Frequency: Occasional (HP:0040283). (ORPHA:3449)
- Visual loss (HP:0000572): Loss of visual acuity (implying that vision was better at a certain time point in life). Otherwise the term reduced visual acuity should be used (or a subclass of that). Evidence: TAS. Frequency: Occasional (HP:0040283). (ORPHA:3449)
- Mild intellectual disability (HP:0001256): Mild intellectual disability (ID) is defined as a type of ID characterized by mildly sub-average adaptive functioning and intellectual functioning, with an intelligence quotient (IQ) the range of 50-69. Evidence: TAS. Frequency: Occasional (HP:0040283). (ORPHA:3449)
- Joint stiffness (HP:0001387): Joint stiffness is a perceived sensation of tightness in a joint or joints when attempting to move them after a period of inactivity. Joint stiffness typically subsides over time. Evidence: TAS. Frequency: Occasional (HP:0040283). (ORPHA:3449)
- Ventricular septal defect (HP:0001629): A hole between the two bottom chambers (ventricles) of the heart. The defect is centered around the most superior aspect of the ventricular septum. Evidence: TAS. Frequency: Occasional (HP:0040283). (ORPHA:3449)
- Pulmonic stenosis (HP:0001642): A narrowing of the right ventricular outflow tract that can occur at the pulmonary valve (valvular stenosis), below the pulmonary valve (infundibular stenosis), or above the pulmonary valve (supravalvar stenosis). Evidence: TAS. Frequency: Occasional (HP:0040283). (ORPHA:3449)
- Patent ductus arteriosus (HP:0001643): In utero, the ductus arteriosus (DA) serves to divert ventricular output away from the lungs and toward the placenta by connecting the main pulmonary artery to the descending aorta. A patent ductus arteriosus (PDA) in the first 3 days of life is a physiologic shunt in healthy term and preterm newborn infants, and normally is substantially closed within about 24 hours after bith and completely closed after about three weeks. Failure of physiologcal closure is referred to a persistent or patent ductus arteriosus (PDA). Depending on the degree of left-to-right shunting, PDA can have clinical consequences. Evidence: TAS. Frequency: Occasional (HP:0040283). (ORPHA:3449)
- Aortic valve stenosis (HP:0001650): The presence of a stenosis (narrowing) of the aortic valve. Evidence: TAS. Frequency: Occasional (HP:0040283). (ORPHA:3449)
- Mitral regurgitation (HP:0001653): An abnormality of the mitral valve characterized by insufficiency or incompetence of the mitral valve resulting in retrograde leaking of blood through the mitral valve upon ventricular contraction. Evidence: TAS. Frequency: Occasional (HP:0040283). (ORPHA:3449)
- Delayed skeletal maturation (HP:0002750): A decreased rate of skeletal maturation. Delayed skeletal maturation can be diagnosed on the basis of an estimation of the bone age from radiographs of specific bones in the human body. Evidence: TAS. Frequency: Occasional (HP:0040283). (ORPHA:3449)
- Prolonged QTc interval (HP:0005184): A longer than normal interval (corrected for heart rate) between the Q and T waves in the heart's cycle. Prolonged QTc can cause premature action potentials during late phase depolarizations thereby leading to ventricular arrhythmias and ventricular fibrillations. Evidence: TAS. Frequency: Occasional (HP:0040283). (ORPHA:3449)
These phenotypes are associated with the disease Weill-Marchesani syndrome (ORPHA:3449).